- Sinusitis (HP:0000246): Inflammation of the paranasal sinuses owing to a viral, bacterial, or fungal infection, allergy, or an autoimmune reaction. Evidence: TAS. Frequency: Frequent (HP:0040282). (ORPHA:73263)
- Fever (HP:0001945): Body temperature elevated above the normal range. Evidence: TAS. Frequency: Frequent (HP:0040282). (ORPHA:73263)
- Fatigue (HP:0012378): A subjective feeling of tiredness characterized by a lack of energy and motivation. Evidence: TAS. Frequency: Frequent (HP:0040282). (ORPHA:73263)
- Pain (HP:0012531): An unpleasant sensory and emotional experience associated with actual or potential tissue damage, or described in terms of such damage. Evidence: TAS. Frequency: Frequent (HP:0040282). (ORPHA:73263)
- Cough (HP:0012735): A sudden, audible expulsion of air from the lungs through a partially closed glottis, preceded by inhalation. Evidence: TAS. Frequency: Frequent (HP:0040282). (ORPHA:73263)
- Unusual skin infection (HP:0032162): Increased susceptibility to infection of the skin, nails, or mucous membranes, as manifested by recurrent or severe cutaneous or mucosal infection, or by skin or mucous membrane infection caused by an atypical or opportunistic organism. Evidence: TAS. Frequency: Frequent (HP:0040282). (ORPHA:73263)
- Visual loss (HP:0000572): Loss of visual acuity (implying that vision was better at a certain time point in life). Otherwise the term reduced visual acuity should be used (or a subclass of that). Evidence: TAS. Frequency: Occasional (HP:0040283). (ORPHA:73263)
- Blurred vision (HP:0000622): Lack of sharpness of vision resulting in the inability to see fine detail. Evidence: TAS. Frequency: Occasional (HP:0040283). (ORPHA:73263)
- Periorbital fullness (HP:0000629): Increase in periorbital soft tissue. Evidence: TAS. Frequency: Occasional (HP:0040283). (ORPHA:73263)
- Diabetes mellitus (HP:0000819): A group of abnormalities characterized by hyperglycemia and glucose intolerance. Evidence: TAS. Frequency: Occasional (HP:0040283). (ORPHA:73263)
- Abnormal cranial nerve morphology (HP:0001291): Structural abnormality affecting one or more of the cranial nerves, which emerge directly from the brain stem. Evidence: TAS. Frequency: Occasional (HP:0040283). (ORPHA:73263)
- Premature birth (HP:0001622): The birth of a baby of less than 37 weeks of gestational age. Evidence: TAS. Frequency: Occasional (HP:0040283). (ORPHA:73263)
- Nasal congestion (HP:0001742): Reduced ability to pass air through the nasal cavity often leading to mouth breathing. Evidence: TAS. Frequency: Occasional (HP:0040283). (ORPHA:73263)
- Decreased total neutrophil count (HP:0001875): Abnormal decrease of absolute number of neutrophils in the blood, per microlitre, compared to a reference range for a given sex and age-group. Evidence: TAS. Frequency: Occasional (HP:0040283). (ORPHA:73263)
- Ketoacidosis (HP:0001993): Acidosis resulting from accumulation of ketone bodies. Evidence: TAS. Frequency: Occasional (HP:0040283). (ORPHA:73263)
- Vomiting (HP:0002013): Forceful ejection of the contents of the stomach through the mouth by means of a series of involuntary spasmic contractions. Evidence: TAS. Frequency: Occasional (HP:0040283). (ORPHA:73263)
- Diarrhea (HP:0002014): Abnormally increased frequency (usually defined as three or more) loose or watery bowel movements a day. Evidence: TAS. Frequency: Occasional (HP:0040283). (ORPHA:73263)
- Nausea (HP:0002018): A sensation of unease in the stomach together with an urge to vomit. Evidence: TAS. Frequency: Occasional (HP:0040283). (ORPHA:73263)
- Abdominal pain (HP:0002027): An unpleasant sensation characterized by physical discomfort (such as pricking, throbbing, or aching) and perceived to originate in the abdomen. Evidence: TAS. Frequency: Occasional (HP:0040283). (ORPHA:73263)
- Hemoptysis (HP:0002105): Coughing up (expectoration) of blood or blood-streaked sputum from the larynx, trachea, bronchi, or lungs. Evidence: TAS. Frequency: Occasional (HP:0040283). (ORPHA:73263)
- Pneumothorax (HP:0002107): Accumulation of air in the pleural cavity leading to a partially or completely collapsed lung. Evidence: TAS. Frequency: Occasional (HP:0040283). (ORPHA:73263)
- Pulmonary infiltrates (HP:0002113). Evidence: TAS. Frequency: Occasional (HP:0040283). (ORPHA:73263)
- Pleural effusion (HP:0002202): The presence of an excessive amount of fluid in the pleural cavity. Evidence: TAS. Frequency: Occasional (HP:0040283). (ORPHA:73263)
- Hematemesis (HP:0002248): The vomiting of blood. Evidence: TAS. Frequency: Occasional (HP:0040283). (ORPHA:73263)
- Headache (HP:0002315): Cephalgia, or pain sensed in various parts of the head, not confined to the area of distribution of any nerve. Evidence: TAS. Frequency: Occasional (HP:0040283). (ORPHA:73263)
- Infectious encephalitis (HP:0002383): A disorder of the brain caused by an infectious agent that presents with fever, headache, and an altered level of consciousness. There may also be focal or multifocal neurologic deficits, and focal or generalized seizure activity. Evidence: TAS. Frequency: Occasional (HP:0040283). (ORPHA:73263)
- Colitis (HP:0002583): Colitis refers to an inflammation of the colon and is often used to describe an inflammation of the large intestine (colon, cecum and rectum). Colitides may be acute and self-limited or chronic, and broadly fit into the category of digestive diseases. Evidence: TAS. Frequency: Occasional (HP:0040283). (ORPHA:73263)
- Hematological neoplasm (HP:0004377): Neoplasms located in the blood and blood-forming tissue (the bone marrow and lymphatic tissue). Evidence: TAS. Frequency: Occasional (HP:0040283). (ORPHA:73263)
- Enterocolitis (HP:0004387): An inflammation of the colon and small intestine. However, most conditions are either categorized as Enteritis (inflammation of the small intestine) or Colitis (inflammation of the large intestine). Evidence: TAS. Frequency: Occasional (HP:0040283). (ORPHA:73263)
- Gastritis (HP:0005263): The presence of inflammation of the gastric mucous membrane. Evidence: TAS. Frequency: Occasional (HP:0040283). (ORPHA:73263)
- Abnormal blistering of the skin (HP:0008066): The presence of one or more bullae on the skin, defined as fluid-filled blisters more than 5 mm in diameter with thin walls. Evidence: TAS. Frequency: Occasional (HP:0040283). (ORPHA:73263)
- Acute infectious pneumonia (HP:0011949): Acute inflammation of the lung due to an infection. Evidence: TAS. Frequency: Occasional (HP:0040283). (ORPHA:73263)
- Rhinorrhea (HP:0031417): Increased discharge of mucus from the nose. Evidence: TAS. Frequency: Occasional (HP:0040283). (ORPHA:73263)
- Unusual gastrointestinal infection (HP:0032166). Evidence: TAS. Frequency: Occasional (HP:0040283). (ORPHA:73263)
- Air crescent (HP:0033661): An air crescent is a collection of air in a crescentic shape that separates the wall of a cavity from an inner mass. The air crescent sign is often considered characteristic of either Aspergillus colonization of preexisting cavities or retraction of infarcted lung in angioinvasive aspergillosis. However, the air crescent sign has also been reported in other conditions, including tuberculosis, Wegener granulomatosis, intracavitary hemorrhage, and lung cancer. The crescent can be seen in both plain X-ray and CT scan. Evidence: TAS. Frequency: Occasional (HP:0040283). (ORPHA:73263)
- Parenchymal consolidation (HP:0032177): Consolidation refers to an exudate or other product of disease that replaces alveolar air, rendering the lung solid (as in infective pneumonia). Evidence: TAS. Frequency: Occasional (HP:0040283). (ORPHA:73263)
- Ileitis (HP:0032564): Inflammation of the ileum. Evidence: TAS. Frequency: Occasional (HP:0040283). (ORPHA:73263)
- Cutaneous wound (HP:0032674): A cutaneous wound is a defined as a disruption of normal anatomic structure and function of the skin that occurs owing to an injury of the skin. Wound healing is a dynamic, interactive process involving soluble mediators, blood cells, extracellularmatrix, and parenchymal cells. Wound healing has three phases: inflammation, tissue formation, and tissue remodeling, that overlap in time. Evidence: TAS. Frequency: Occasional (HP:0040283). (ORPHA:73263)
- Abnormal mediastinum morphology (HP:0045026): Any structural anomaly of the central compartment of the thoracic cavity. Evidence: TAS. Frequency: Occasional (HP:0040283). (ORPHA:73263)
- Fasciitis (HP:0100537): Inflammation of fascia, the tissue under the skin and over the muscle. Evidence: TAS. Frequency: Occasional (HP:0040283). (ORPHA:73263)
- Periorbital edema (HP:0100539): Edema affecting the region situated around the orbit of the eye. Evidence: TAS. Frequency: Occasional (HP:0040283). (ORPHA:73263)
- Cellulitis (HP:0100658): A bacterial infection and inflammation of the skin und subcutaneous tissues. Evidence: TAS. Frequency: Occasional (HP:0040283). (ORPHA:73263)
- Mediastinal lymphadenopathy (HP:0100721): Swelling of lymph nodes within the mediastinum, the central compartment of the thoracic cavities that contains the heart and the great vessels, the esophagus, and trachea and other structures including lymph nodes. Evidence: TAS. Frequency: Occasional (HP:0040283). (ORPHA:73263)
- Chest pain (HP:0100749): An unpleasant sensation characterized by physical discomfort (such as pricking, throbbing, or aching) localized to the chest. Evidence: TAS. Frequency: Occasional (HP:0040283). (ORPHA:73263)
- Atelectasis (HP:0100750): Collapse of part of a lung associated with absence of inflation (air) of that part. Evidence: TAS. Frequency: Occasional (HP:0040283). (ORPHA:73263)
- Skin plaque (HP:0200035): A plaque is a solid, raised, plateau-like (flat-topped) lesion greater than 1 cm in diameter. Evidence: TAS. Frequency: Occasional (HP:0040283). (ORPHA:73263)
- Pustule (HP:0200039): A small elevation of the skin containing cloudy or purulent material usually consisting of necrotic inflammatory cells. Evidence: TAS. Frequency: Occasional (HP:0040283). (ORPHA:73263)
- Renal insufficiency (HP:0000083): A reduction in the level of performance of the kidneys in areas of function comprising the concentration of urine, removal of wastes, the maintenance of electrolyte balance, homeostasis of blood pressure, and calcium metabolism. Evidence: TAS. Frequency: Very rare (HP:0040284). (ORPHA:73263)
- Nephritis (HP:0000123): The presence of inflammation affecting the kidney. Evidence: TAS. Frequency: Very rare (HP:0040284). (ORPHA:73263)
- Mastoiditis (HP:0000265): Infection of the mastoid air cells, arising as a complication of otitis media or occurring in the context of unusual susceptibility to infection. Evidence: TAS. Frequency: Very rare (HP:0040284). (ORPHA:73263)
- Epistaxis (HP:0000421): Epistaxis, or nosebleed, refers to a hemorrhage localized in the nose. Evidence: TAS. Frequency: Very rare (HP:0040284). (ORPHA:73263)
- Ptosis (HP:0000508): The upper eyelid margin is positioned 3 mm or more lower than usual and covers the superior portion of the iris (objective); or, the upper lid margin obscures at least part of the pupil (subjective). Evidence: TAS. Frequency: Very rare (HP:0040284). (ORPHA:73263)
- Proptosis (HP:0000520): An eye that is protruding anterior to the plane of the face to a greater extent than is typical. Evidence: TAS. Frequency: Very rare (HP:0040284). (ORPHA:73263)
- Retinal detachment (HP:0000541): Separation of the inner layers of the retina (neural retina) from the pigment epithelium. Evidence: TAS. Frequency: Very rare (HP:0040284). (ORPHA:73263)
- External ophthalmoplegia (HP:0000544): Paralysis of the external ocular muscles. Evidence: TAS. Frequency: Very rare (HP:0040284). (ORPHA:73263)
- Diplopia (HP:0000651): Diplopia is a condition in which a single object is perceived as two images, it is also known as double vision. Evidence: TAS. Frequency: Very rare (HP:0040284). (ORPHA:73263)
- Pericarditis (HP:0001701): Inflammation of the sac-like covering around the heart (pericardium). Evidence: TAS. Frequency: Very rare (HP:0040284). (ORPHA:73263)
- Pancreatitis (HP:0001733): The presence of inflammation in the pancreas. Evidence: TAS. Frequency: Very rare (HP:0040284). (ORPHA:73263)
- Gastrointestinal hemorrhage (HP:0002239): Hemorrhage affecting the gastrointestinal tract. Evidence: TAS. Frequency: Very rare (HP:0040284). (ORPHA:73263)
- Melena (HP:0002249): The passage of blackish, tarry feces associated with gastrointestinal hemorrhage. Melena occurs if the blood remains in the colon long enough for it to be broken down by colonic bacteria. One degradation product, hematin, imbues the stool with a blackish color. Thus, melena generally occurs with bleeding from the upper gastrointestinal tract (e.g., stomach ulcers or duodenal ulcers), since the blood usually remains in the gut for a longer period of time than with lower gastrointestinal bleeding. Evidence: TAS. Frequency: Very rare (HP:0040284). (ORPHA:73263)
- Hematochezia (HP:0002573): The passage of fresh (red) blood per anus, usually in or with stools. Most rectal bleeding comes from the colon, rectum, or anus. Evidence: TAS. Frequency: Very rare (HP:0040284). (ORPHA:73263)
- Peritonitis (HP:0002586): Inflammation of the peritoneum. Evidence: TAS. Frequency: Very rare (HP:0040284). (ORPHA:73263)
- Osteolysis (HP:0002797): Osteolysis refers to the destruction of bone through bone resorption with removal or loss of calcium. Evidence: TAS. Frequency: Very rare (HP:0040284). (ORPHA:73263)
- Thrombophlebitis (HP:0004418): Inflammation of a vein associated with venous thrombosis (blood clot formation within the vein). Evidence: TAS. Frequency: Very rare (HP:0040284). (ORPHA:73263)
- Arterial thrombosis (HP:0004420): The formation of a blood clot inside an artery. Evidence: TAS. Frequency: Very rare (HP:0040284). (ORPHA:73263)
- Dilatation of the cerebral artery (HP:0004944): The presence of a localized dilatation or ballooning of a cerebral artery. Evidence: TAS. Frequency: Very rare (HP:0040284). (ORPHA:73263)
- Loss of consciousness (HP:0007185): Loss of awareness of oneself or one's surroundings, involving (i) a loss of normal motor control is evident as flaccidity or stiffness, either of which can be accompanied by jerking movements, and postural control is lost so that patients fall if they are in an upright position; (ii) normal responsiveness is lost; and (iii) the patient experiences amnesia for the event. Loss of consciousness my be transitory (e.g., syncope) or prolonged. Evidence: TAS. Frequency: Very rare (HP:0040284). (ORPHA:73263)
- Hepatitis (HP:0012115): Inflammation of the liver. Evidence: TAS. Frequency: Very rare (HP:0040284). (ORPHA:73263)
- Chemosis (HP:0012375): Edema (swelling) of the bulbar conjunctiva. Evidence: TAS. Frequency: Very rare (HP:0040284). (ORPHA:73263)
- Myocarditis (HP:0012819): Inflammation of the myocardium. Evidence: TAS. Frequency: Very rare (HP:0040284). (ORPHA:73263)
- Invasive fungal infection (HP:0020101): Fungal infection characterized by invasion of host tissues. Evidence: TAS. Frequency: Very rare (HP:0040284). (ORPHA:73263)
- Splenic abscess (HP:0025059): A circumscribed area of pus or necrotic debris in the parenchyma of the spleen. Evidence: TAS. Frequency: Very rare (HP:0040284). (ORPHA:73263)
- Retinal arterial occlusion (HP:0025326): Blockage of the retinal artery, generally associated with interruption of blood flow and oxygen delivery to the retina. Evidence: TAS. Frequency: Very rare (HP:0040284). (ORPHA:73263)
- Brain abscess (HP:0030049): A collection of pus, immune cells, and other material in the brain. Evidence: TAS. Frequency: Very rare (HP:0040284). (ORPHA:73263)
- Colon perforation (HP:0031369): A hole (perforation) in the wall of the colon. Evidence: TAS. Frequency: Very rare (HP:0040284). (ORPHA:73263)
- Endocarditis (HP:0100584): An inflammation of the endocardium, the inner layer of the heart, which usually involves the heart valves. Evidence: TAS. Frequency: Very rare (HP:0040284). (ORPHA:73263)
These phenotypes are associated with the disease Zygomycosis (ORPHA:73263).